- Juvenile onset (HP:0003621): Onset of signs or symptoms of disease between the age of 5 and 15 years. Evidence: PCS. Frequency: 6/7. (PMID:29309402)
- Sensorineural hearing impairment (HP:0000407): A type of hearing impairment in one or both ears related to an abnormal functionality of the cochlear nerve. Evidence: PCS. Frequency: 7/7. (PMID:29309402)
- Childhood onset (HP:0011463): Onset of disease at the age of between 1 and 5 years. Evidence: PCS. Frequency: 1/7. (PMID:29309402)
- Autosomal dominant inheritance (HP:0000006): A mode of inheritance that is observed for traits related to a gene encoded on one of the autosomes (i.e., the human chromosomes 1-22) in which a trait manifests in heterozygotes. In the context of medical genetics, an autosomal dominant disorder is caused when a single copy of the mutant allele is present. Males and females are affected equally, and can both transmit the disorder with a risk of 50% for each child of inheriting the mutant allele. Evidence: PCS. (PMID:29309402)
These phenotypes are associated with the disease hearing loss, autosomal dominant 73 (OMIM:617663).